Phenotypes associated with the disease Gastroschisis (ORPHA:2368):
- Gastroschisis (HP:0001543): A type of congenital ventral incomplete closure of the abdominal wall in which the intestines and sometimes other organs extend freely into the amniotic fluid space through a small opening in the abdomen, usually to the right of the umbilicus. Evidence: TAS. Frequency: Very frequent (HP:0040281). (ORPHA:2368)
- Intrauterine growth retardation (HP:0001511): An abnormal restriction of fetal growth with fetal weight below the tenth percentile for gestational age. Evidence: TAS. Frequency: Frequent (HP:0040282). (ORPHA:2368)
- Abnormality of the umbilical cord (HP:0010881): An abnormality of the umbilical cord, which is the cord connecting the developing embryo or fetus to the placenta. Evidence: TAS. Frequency: Frequent (HP:0040282). (ORPHA:2368)
- Elevated maternal circulating alpha-fetoprotein concentration (HP:0011432): Increase in the levels of maternal serum alpha-fetoprotein levels during pregnancy. Evidence: TAS. Frequency: Frequent (HP:0040282). (ORPHA:2368)
- Abnormal fetal gastrointestinal system morphology (HP:0034207): An anomalous structural finding of the fetal gastrointestinal system. Terms in this subhierarchy are restricted to findings that can only be observed in the prenatal period. Other HPO terms can also be used to describe fetal phenotypes. Evidence: TAS. Frequency: Frequent (HP:0040282). (ORPHA:2368)
- Polyhydramnios (HP:0001561): The presence of excess amniotic fluid in the uterus during pregnancy. Evidence: TAS. Frequency: Occasional (HP:0040283). (ORPHA:2368)
- Oligohydramnios (HP:0001562): Diminished amniotic fluid volume in pregnancy. Evidence: TAS. Frequency: Occasional (HP:0040283). (ORPHA:2368)
- Premature birth (HP:0001622): The birth of a baby of less than 37 weeks of gestational age. Evidence: TAS. Frequency: Occasional (HP:0040283). (ORPHA:2368)
- Intestinal malrotation (HP:0002566): An abnormality of the intestinal rotation and fixation that normally occurs during the development of the gut. This can lead to volvulus, or twisting of the intestine that causes obstruction and necrosis. Evidence: TAS. Frequency: Occasional (HP:0040283). (ORPHA:2368)
- Volvulus (HP:0002580): Abnormal twisting of a portion of intestine around itself or around a stalk of mesentery tissue. Evidence: TAS. Frequency: Occasional (HP:0040283). (ORPHA:2368)
- Intestinal atresia (HP:0011100): An abnormal closure, or atresia of the tubular structure of the intestine. Evidence: TAS. Frequency: Occasional (HP:0040283). (ORPHA:2368)
- Intestinal perforation (HP:0031368): A hole (perforation) in the wall of the intestine. Evidence: TAS. Frequency: Occasional (HP:0040283). (ORPHA:2368)
- Abnormal mesentery morphology (HP:0100016): Folds of membranous tissue (peritoneum, mesothelium) attached to the wall of the abdomen and enclosing viscera. Examples include the mesentery for the small intestine; the transverse mesocolon, which attaches the transverse portion of the colon to the back wall of the abdomen; and the mesosigmoid, which enfolds the sigmoid portion of the colon. Cells of the same embryologic origin also surround the other organs of the body such as the lungs (pleura) or the heart (pericardium). Evidence: TAS. Frequency: Occasional (HP:0040283). (ORPHA:2368)